- Broad distal phalanx of the toes (HP:0010186): Increased width of the distal phalanx of toe of one or more toes. Evidence: TAS. (OMIM:602071)
- Autosomal dominant inheritance (HP:0000006): A mode of inheritance that is observed for traits related to a gene encoded on one of the autosomes (i.e., the human chromosomes 1-22) in which a trait manifests in heterozygotes. In the context of medical genetics, an autosomal dominant disorder is caused when a single copy of the mutant allele is present. Males and females are affected equally, and can both transmit the disorder with a risk of 50% for each child of inheriting the mutant allele. Evidence: TAS. (OMIM:602071)
- Broad distal phalanx of finger (HP:0009836): Abnormally wide (broad) distal phalanx of finger. Evidence: TAS. (OMIM:602071)
These phenotypes are associated with the disease broad terminal phalanges, familial (OMIM:602071).